Phenotypes associated with the disease Hemorrhagic fever-renal syndrome (ORPHA:340):
- Acute kidney injury (HP:0001919): Sudden loss of renal function, as manifested by decreased urine production, and a rise in serum creatinine or blood urea nitrogen concentration (azotemia). Evidence: TAS. Frequency: Very frequent (HP:0040281). (ORPHA:340)
- Fever (HP:0001945): Body temperature elevated above the normal range. Evidence: TAS. Frequency: Very frequent (HP:0040281). (ORPHA:340)
- Elevated circulating creatinine concentration (HP:0003259): An increased amount of creatinine in the blood. Evidence: TAS. Frequency: Very frequent (HP:0040281). (ORPHA:340)
- Decreased urine output (HP:0011037): A decreased rate of urine production. Evidence: TAS. Frequency: Very frequent (HP:0040281). (ORPHA:340)
- Decreased glomerular filtration rate (HP:0012213): An abnormal reduction in the volume of fluid filtered out of plasma through glomerular capillary walls into Bowman's capsules per unit of time. Evidence: TAS. Frequency: Very frequent (HP:0040281). (ORPHA:340)
- Capillary leak (HP:0030005): An acute phenomenon characterized by hypotension and anasarca due to the loss of plasma volume into peripheral tissues, with evidence of decreased plasma volume (hemoconcentration) and protein loss from the intravascular space (hypoalbuminemia) during acute episodes. Evidence: TAS. Frequency: Very frequent (HP:0040281). (ORPHA:340)
- Severe infection (HP:0032169): A type of infection that is regarded as a sign of a pathological susceptibility to infection because of unusual severity or intensity of the infection. Evidence: TAS. Frequency: Very frequent (HP:0040281). (ORPHA:340)
- Oliguria (HP:0100520): Low output of urine, clinically classified as an output below 300-500ml/day. Evidence: TAS. Frequency: Very frequent (HP:0040281). (ORPHA:340)
- Proteinuria (HP:0000093): Increased levels of protein in the urine. Evidence: TAS. Frequency: Frequent (HP:0040282). (ORPHA:340)
- Glomerulonephritis (HP:0000099): Inflammation of the renal glomeruli. Evidence: TAS. Frequency: Frequent (HP:0040282). (ORPHA:340)
- Blurred vision (HP:0000622): Lack of sharpness of vision resulting in the inability to see fine detail. Evidence: TAS. Frequency: Frequent (HP:0040282). (ORPHA:340)
- Petechiae (HP:0000967): Petechiae are pinpoint-sized reddish/purple spots, resembling a rash, that appear just under the skin or a mucous membrane when capillaries have ruptured and some superficial bleeding into the skin has happened. This term refers to an abnormally increased susceptibility to developing petechiae. Evidence: TAS. Frequency: Frequent (HP:0040282). (ORPHA:340)
- Excessive daytime somnolence (HP:0001262): A state of abnormally strong desire for sleep during the daytime. Evidence: TAS. Frequency: Frequent (HP:0040282). (ORPHA:340)
- Muscle weakness (HP:0001324): Reduced strength of muscles. Evidence: TAS. Frequency: Frequent (HP:0040282). (ORPHA:340)
- Tachycardia (HP:0001649): A rapid heartrate that exceeds the range of the normal resting heartrate for age. Evidence: TAS. Frequency: Frequent (HP:0040282). (ORPHA:340)
- Thrombocytopenia (HP:0001873): A reduction in the number of circulating thrombocytes. Evidence: TAS. Frequency: Frequent (HP:0040282). (ORPHA:340)
- Palpitations (HP:0001962): A sensation that the heart is pounding or racing, which is a non-specific sign but may be a manifestation of arrhythmia. Evidence: TAS. Frequency: Frequent (HP:0040282). (ORPHA:340)
- Tubulointerstitial nephritis (HP:0001970): A form of inflammation of the kidney affecting the interstitium of the kidneys surrounding the tubules. Evidence: TAS. Frequency: Frequent (HP:0040282). (ORPHA:340)
- Increased total leukocyte count (HP:0001974): An abnormal increase in the number of leukocytes in the blood. Evidence: TAS. Frequency: Frequent (HP:0040282). (ORPHA:340)
- Vomiting (HP:0002013): Forceful ejection of the contents of the stomach through the mouth by means of a series of involuntary spasmic contractions. Evidence: TAS. Frequency: Frequent (HP:0040282). (ORPHA:340)
- Nausea (HP:0002018): A sensation of unease in the stomach together with an urge to vomit. Evidence: TAS. Frequency: Frequent (HP:0040282). (ORPHA:340)
- Abdominal pain (HP:0002027): An unpleasant sensation characterized by physical discomfort (such as pricking, throbbing, or aching) and perceived to originate in the abdomen. Evidence: TAS. Frequency: Frequent (HP:0040282). (ORPHA:340)
- Headache (HP:0002315): Cephalgia, or pain sensed in various parts of the head, not confined to the area of distribution of any nerve. Evidence: TAS. Frequency: Frequent (HP:0040282). (ORPHA:340)
- Hypotension (HP:0002615): Low Blood Pressure, vascular hypotension. Evidence: TAS. Frequency: Frequent (HP:0040282). (ORPHA:340)
- Myalgia (HP:0003326): Pain in muscle. Evidence: TAS. Frequency: Frequent (HP:0040282). (ORPHA:340)
- Back pain (HP:0003418): An unpleasant sensation characterized by physical discomfort (such as pricking, throbbing, or aching) localized to the back. Evidence: TAS. Frequency: Frequent (HP:0040282). (ORPHA:340)
- Decreased body weight (HP:0004325): Abnormally low body weight. Evidence: TAS. Frequency: Frequent (HP:0040282). (ORPHA:340)
- Acute tubulointerstitial nephritis (HP:0004729): Acute inflammation of the kidney affecting the interstitium of the kidneys surrounding the tubules. Evidence: TAS. Frequency: Frequent (HP:0040282). (ORPHA:340)
- Fatigue (HP:0012378): A subjective feeling of tiredness characterized by a lack of energy and motivation. Evidence: TAS. Frequency: Frequent (HP:0040282). (ORPHA:340)
- Chills (HP:0025143): A sudden sensation of feeling cold. Evidence: TAS. Frequency: Frequent (HP:0040282). (ORPHA:340)
- Increased circulating interleukin 6 concentration (HP:0030783): The concentration of interleukin-6 in the blood circulation is above the upper limit of normal. Evidence: TAS. Frequency: Frequent (HP:0040282). (ORPHA:340)
- Agitation (HP:0000713): A state of excessive motor activity that is associated with mental distress or a feeling of substantial unease or inner tension. Distinguished from restlessness by the increased level of emotional distress and negative intensity of the experience. Agitation has a significant level of physical activity that is typically threatening to the self or others. Evidence: TAS. Frequency: Occasional (HP:0040283). (ORPHA:340)
- Hematuria (HP:0000790): The presence of blood in the urine. Hematuria may be gross hematuria (visible to the naked eye) or microscopic hematuria (detected by dipstick or microscopic examination of the urine). Evidence: TAS. Frequency: Occasional (HP:0040283). (ORPHA:340)
- Hyperhidrosis (HP:0000975): Abnormal excessive perspiration (sweating) despite the lack of appropriate stimuli like hot and humid weather. Evidence: TAS. Frequency: Occasional (HP:0040283). (ORPHA:340)
- Confusion (HP:0001289): Lack of clarity and coherence of thought, perception, understanding, or action. Evidence: TAS. Frequency: Occasional (HP:0040283). (ORPHA:340)
- Anemia (HP:0001903): A reduction in erythrocytes volume or hemoglobin concentration. Evidence: TAS. Frequency: Occasional (HP:0040283). (ORPHA:340)
- Diarrhea (HP:0002014): Abnormally increased frequency (usually defined as three or more) loose or watery bowel movements a day. Evidence: TAS. Frequency: Occasional (HP:0040283). (ORPHA:340)
- Pneumonia (HP:0002090): Inflammation of any part of the lung parenchyma. Evidence: TAS. Frequency: Occasional (HP:0040283). (ORPHA:340)
- Dyspnea (HP:0002094): Difficult or labored breathing. Dyspnea is a subjective feeling only the patient can rate, e.g., on a Borg scale. Evidence: TAS. Frequency: Occasional (HP:0040283). (ORPHA:340)
- Respiratory distress (HP:0002098): Respiratory distress is objectively observable as the physical or emotional consequences from the experience of dyspnea. The physical presentation of respiratory distress is generally referred to as labored breathing, while the sensation of respiratory distress is called shortness of breath or dyspnea. Evidence: TAS. Frequency: Occasional (HP:0040283). (ORPHA:340)
- Hyperkalemia (HP:0002153): The concentration of potassium(1+) in the blood circulation is above the upper limit of normal. Evidence: TAS. Frequency: Occasional (HP:0040283). (ORPHA:340)
- Pleural effusion (HP:0002202): The presence of an excessive amount of fluid in the pleural cavity. Evidence: TAS. Frequency: Occasional (HP:0040283). (ORPHA:340)
- Hematemesis (HP:0002248): The vomiting of blood. Evidence: TAS. Frequency: Occasional (HP:0040283). (ORPHA:340)
- Hyperphosphatemia (HP:0002905): The concentration of phosphate ion in the blood circulation is above the upper limit of normal. Evidence: TAS. Frequency: Occasional (HP:0040283). (ORPHA:340)
- Elevated circulating hepatic transaminase concentration (HP:0002910): Elevations of the levels of SGOT and SGPT in the serum. SGOT (serum glutamic oxaloacetic transaminase) and SGPT (serum glutamic pyruvic transaminase) are transaminases primarily found in the liver and heart and are released into the bloodstream as the result of liver or heart damage. SGOT and SGPT are used clinically mainly as markers of liver damage. Evidence: TAS. Frequency: Occasional (HP:0040283). (ORPHA:340)
- Subconjunctival hemorrhage (HP:0011896): Bleeding beneath the mucous membrane that lines the inner surface of the eyelid. Evidence: TAS. Frequency: Occasional (HP:0040283). (ORPHA:340)
- Cough (HP:0012735): A sudden, audible expulsion of air from the lungs through a partially closed glottis, preceded by inhalation. Evidence: TAS. Frequency: Occasional (HP:0040283). (ORPHA:340)
- Shock (HP:0031273): The state in which profound and widespread reduction of effective tissue perfusion leads first to reversible, and then if prolonged, to irreversible cellular injury. Evidence: TAS. Frequency: Occasional (HP:0040283). (ORPHA:340)
- Ecchymosis (HP:0031364): A purpuric lesion that is larger than 1 cm in diameter. Evidence: TAS. Frequency: Occasional (HP:0040283). (ORPHA:340)
- Anuria (HP:0100519): Absence of urine, clinically classified as below 50ml/day. Evidence: TAS. Frequency: Occasional (HP:0040283). (ORPHA:340)
- Pulmonary edema (HP:0100598): Fluid accumulation in the lungs. Evidence: TAS. Frequency: Occasional (HP:0040283). (ORPHA:340)
- Insomnia (HP:0100785): Persistent difficulty in starting or maintaining sleep, or waking up earlier than desired, despite having adequate opportunities and conditions for sleep. Evidence: TAS. Frequency: Occasional (HP:0040283). (ORPHA:340)
- Epistaxis (HP:0000421): Epistaxis, or nosebleed, refers to a hemorrhage localized in the nose. Evidence: TAS. Frequency: Very rare (HP:0040284). (ORPHA:340)
- Hypertension (HP:0000822): The presence of chronic increased pressure in the systemic arterial system. Evidence: TAS. Frequency: Very rare (HP:0040284). (ORPHA:340)
- Coma (HP:0001259): The complete absence of wakefulness and consciousness, which is evident through a lack of response to any form of external stimuli. Evidence: TAS. Frequency: Very rare (HP:0040284). (ORPHA:340)
- Intracranial hemorrhage (HP:0002170): Hemorrhage occurring within the skull. Evidence: TAS. Frequency: Very rare (HP:0040284). (ORPHA:340)
- Melena (HP:0002249): The passage of blackish, tarry feces associated with gastrointestinal hemorrhage. Melena occurs if the blood remains in the colon long enough for it to be broken down by colonic bacteria. One degradation product, hematin, imbues the stool with a blackish color. Thus, melena generally occurs with bleeding from the upper gastrointestinal tract (e.g., stomach ulcers or duodenal ulcers), since the blood usually remains in the gut for a longer period of time than with lower gastrointestinal bleeding. Evidence: TAS. Frequency: Very rare (HP:0040284). (ORPHA:340)
- Respiratory failure (HP:0002878): A severe form of respiratory insufficiency characterized by inadequate gas exchange such that the levels of oxygen or carbon dioxide cannot be maintained within normal limits. Evidence: TAS. Frequency: Very rare (HP:0040284). (ORPHA:340)
- Internal hemorrhage (HP:0011029): The presence of hemorrhage within the body. Evidence: TAS. Frequency: Very rare (HP:0040284). (ORPHA:340)
- Chronic kidney disease (HP:0012622): Functional anomaly of the kidney persisting for at least three months. Evidence: TAS. Frequency: Very rare (HP:0040284). (ORPHA:340)